- Anemia (HP:0001903): A reduction in erythrocytes volume or hemoglobin concentration. Evidence: PCS. (PMID:25424902)
- Hyperpigmentation of the skin (HP:0000953): A darkening of the skin related to an increase in melanin production and deposition. Evidence: PCS. (PMID:25424902)
- Autosomal dominant inheritance (HP:0000006): A mode of inheritance that is observed for traits related to a gene encoded on one of the autosomes (i.e., the human chromosomes 1-22) in which a trait manifests in heterozygotes. In the context of medical genetics, an autosomal dominant disorder is caused when a single copy of the mutant allele is present. Males and females are affected equally, and can both transmit the disorder with a risk of 50% for each child of inheriting the mutant allele. Evidence: PCS. (PMID:25424902)
These phenotypes are associated with the disease Diamond-Blackfan anemia 17 (OMIM:617409).